Phenotypes associated with the disease Pruritic urticarial papules and plaques of pregnancy (ORPHA:64745):
- Eczematoid dermatitis (HP:0000964): Eczema is a form of dermatitis that is characterized by scaly, pruritic, erythematous lesions located on flexural surfaces. Evidence: TAS. Frequency: Very rare (HP:0040284). (ORPHA:64745)
- Pruritus (HP:0000989): Pruritus is an itch or a sensation that makes a person want to scratch. This term refers to an abnormally increased disposition to experience pruritus. Evidence: TAS. Frequency: Very frequent (HP:0040281). (ORPHA:64745)
- Striae distensae (HP:0001065): Thinned, erythematous, depressed bands of atrophic skin. Initially, striae appear as flattened and thinned, pinkish linear regions of the skin. Striae tend to enlarge in length and become reddish or purplish. Later, striae tend to appear as white, depressed bands that are parallel to the lines of skin tension. Striae distensae occur most often in areas that have been subject to distension such as the lower back, buttocks, thighs, breast, abdomen, and shoulders. Evidence: TAS. Frequency: Very frequent (HP:0040281). (ORPHA:64745)
- Erythematous papule (HP:0030350): A circumscribed, solid elevation of skin with no visible fluid that is reddish (erythematous) in color. Evidence: TAS. Frequency: Very frequent (HP:0040281). (ORPHA:64745)
- Urticarial plaque (HP:0030351): A well-circumscribed, intensely pruritic, raised wheal (edema of the superficial skin) typically 1 to 2 cm in diameter. Evidence: TAS. Frequency: Very frequent (HP:0040281). (ORPHA:64745)
- Parakeratosis (HP:0001036): Abnormal formation of the keratinocytes of the epidermis characterized by persistence of nuclei, incomplete formation of keratin, and moistness and swelling of the keratinocytes. Evidence: TAS. Frequency: Frequent (HP:0040282). (ORPHA:64745)
- Increased body weight (HP:0004324): Abnormally increased body weight. Evidence: TAS. Frequency: Frequent (HP:0040282). (ORPHA:64745)
- Erythematous plaque (HP:0025474): A plaque (a solid, raised, plateau-like (flat-topped) lesion greater than 1 cm in diameter) with a red or reddish color often associated with inflammation or irritation. Evidence: TAS. Frequency: Frequent (HP:0040282). (ORPHA:64745)
- Pruritis on abdomen (HP:0030898): Pruritus is an itch or a sensation that makes a person want to scratch. This term refers to an abnormally increased sensation of itching over the skin of the abdomen. Evidence: TAS. Frequency: Frequent (HP:0040282). (ORPHA:64745)
- Skin vesicle (HP:0200037): A circumscribed, fluid-containing, epidermal elevation less than 10mm in diameter at the widest point that (i) Contain serous exudates or serum mixed with blood or pus; (ii) Are discrete, grouped, irregularly distributed, or linear as in Rhus dermatitis; (iii) Are short-lived. Vesicles may break spontaneously or evolve into bullae by enlarging or coalescing with other vesicles. Evidence: TAS. Frequency: Frequent (HP:0040282). (ORPHA:64745)
- Facial erythema (HP:0001041): Redness of the skin of the face, caused by hyperemia of the capillaries in the lower layers of the skin. Evidence: TAS. Frequency: Occasional (HP:0040283). (ORPHA:64745)
- Pruritis on hand (HP:0030899): Pruritus is an itch or a sensation that makes a person want to scratch. This term refers to an abnormally increased sensation of itching over the skin of the hand. Evidence: TAS. Frequency: Occasional (HP:0040283). (ORPHA:64745)
- Pruritus on foot (HP:0030900): Pruritus is an itch or a sensation that makes a person want to scratch. This term refers to an abnormally increased sensation of itching over the skin of the foot. Evidence: TAS. Frequency: Occasional (HP:0040283). (ORPHA:64745)
- Palmar pruritus (HP:0031248): Pruritus is an itch or a sensation that makes a person want to scratch. This term refers to an abnormally increased sensation of itching over the palm(s) of the hand. Evidence: TAS. Frequency: Occasional (HP:0040283). (ORPHA:64745)
- Abnormal dermoepidermal junction morphology (HP:0031538): Any anomaly of the structure of the acellular zone that is between the dermis and the epidermis and which functions to bind the epidermis to the dermis and to serve as a selective barrier allowing the control of molecular and cellular exchanges between the two compartments. Evidence: TAS. Frequency: Occasional (HP:0040283). (ORPHA:64745)
- Abnormality of the plantar skin of foot (HP:0100872): An abnormality of the plantar part of foot, that is of the soles of the feet. Evidence: TAS. Frequency: Occasional (HP:0040283). (ORPHA:64745)
- Abnormal blistering of the skin (HP:0008066): The presence of one or more bullae on the skin, defined as fluid-filled blisters more than 5 mm in diameter with thin walls. Evidence: TAS. Frequency: Very rare (HP:0040284). (ORPHA:64745)
- Palmoplantar erythema (HP:0025493): Redness of the skin of the palm of the hand and the sole of the foot caused by hyperemia of the capillaries in the lower layers of the skin. Evidence: TAS. Frequency: Very rare (HP:0040284). (ORPHA:64745)
- Pruritis on breast (HP:0030901): Pruritus is an itch or a sensation that makes a person want to scratch. This term refers to an abnormally increased sensation of itching over the skin of the breast. Evidence: TAS. Frequency: Very rare (HP:0040284). (ORPHA:64745)
Not associated with this disease:
- Linear IgG deposits along the epidermal basement membrane zone (HP:0031540): Presence of IgG antibodies in the dermoepidermal junction that are distributed in a linear pattern. This feature can be appreciated by immunofluorescence microscopy. Evidence: TAS. (ORPHA:64745)
- Linear C3 deposits along the epidermal basement membrane zone (HP:0031541): Presence of complement C3 in the dermoepidermal junction that are distributed in a linear pattern. This feature can be appreciated by immunofluorescence microscopy. Evidence: TAS. (ORPHA:64745)